Phenotypes associated with the disease thyroid cancer, nonmedullary, 1 (OMIM:188550):
- Papillary thyroid carcinoma (HP:0002895): The presence of a papillary adenocarcinoma of the thyroid gland. Evidence: PCS. (PMID:19176457)
- Non-medullary thyroid carcinoma (HP:0040198). Evidence: TAS. (OMIM:188550)
- Autosomal dominant inheritance (HP:0000006): A mode of inheritance that is observed for traits related to a gene encoded on one of the autosomes (i.e., the human chromosomes 1-22) in which a trait manifests in heterozygotes. In the context of medical genetics, an autosomal dominant disorder is caused when a single copy of the mutant allele is present. Males and females are affected equally, and can both transmit the disorder with a risk of 50% for each child of inheriting the mutant allele. Evidence: PCS. (PMID:19176457)
- Multinodular goiter (HP:0005987): Enlargement of the thyroid gland related to multiple nodules in the thyroid gland. Evidence: PCS. (PMID:19176457)